Phenotypes associated with the disease nonarteritic anterior ischemic optic neuropathy, susceptibility to (OMIM:258660):
- Autosomal recessive inheritance (HP:0000007): A mode of inheritance that is observed for traits related to a gene encoded on one of the autosomes (i.e., the human chromosomes 1-22) in which a trait manifests in individuals with two pathogenic alleles, either homozygotes (two copies of the same mutant allele) or compound heterozygotes (whereby each copy of a gene has a distinct mutant allele). Evidence: IEA. (OMIM:258660)
- Nonarteritic anterior ischemic optic neuropathy (HP:0007634): An acute condition characterized by sudden visual loss (usually discovered in the morning), optic disc edema at onset, optic disc-related visual field defects. Nonarteritic anterior ischemic optic neuropathy can be associated with flame hemorrhages on the swollen disk or nearby neuroretinal layer, and sometimes with nearby cotton-wool exudates. Evidence: IEA. (OMIM:258660)